Phenotypes associated with the disease Herpes simplex virus stromal keratitis (ORPHA:137599):
- Reduced visual acuity (HP:0007663). Evidence: TAS. Frequency: Very frequent (HP:0040281). (ORPHA:137599)
- Deep anterior chamber (HP:0007765): Increased depth of the anterior chamber, i.e., the anteroposterior distance between the cornea and the iris is increased. Evidence: TAS. Frequency: Very frequent (HP:0040281). (ORPHA:137599)
- Corneal stromal edema (HP:0012040): Abnormal accumulation of fluid and swelling of the stroma of cornea. Evidence: TAS. Frequency: Very frequent (HP:0040281). (ORPHA:137599)
- Open angle glaucoma (HP:0012108): A type of glaucoma defined by an open, normal appearing anterior chamber angle and raised intraocular pressure,. Evidence: TAS. Frequency: Very frequent (HP:0040281). (ORPHA:137599)
- Blurred vision (HP:0000622): Lack of sharpness of vision resulting in the inability to see fine detail. Evidence: TAS. Frequency: Frequent (HP:0040282). (ORPHA:137599)
- Herpetiform corneal ulceration (HP:0007812): The presence of one or more dendritic corneal epithelial ulcers characterized by a treelike branching linear pattern with feathery edges and terminal bulbs. Herpetiform corneal ulcers can be identified by fluorescein staining. Evidence: TAS. Frequency: Frequent (HP:0040282). (ORPHA:137599)
- Ocular hypertension (HP:0007906): Intraocular pressure that is 2 standard deviations above the population mean. Evidence: TAS. Frequency: Frequent (HP:0040282). (ORPHA:137599)
- Epiphora (HP:0009926): Abnormally increased lacrimation, that is, excessive tearing (watering eye). Evidence: TAS. Frequency: Frequent (HP:0040282). (ORPHA:137599)
- Descemet Membrane Folds (HP:0012039): Presence of folds in the Descemet membrane, which is the basement membrane of the endothelial (inner) cell layer of the cornea. Descemet membrane folds are generally a manifestation of inflammation or edema of the cornea. Evidence: TAS. Frequency: Frequent (HP:0040282). (ORPHA:137599)
- Decreased corneal sensation (HP:0012155): Reduced ability of the cornea to respond to stimulation. Evidence: TAS. Frequency: Frequent (HP:0040282). (ORPHA:137599)
- Conjunctival hyperemia (HP:0030953): Dilatation of the blood vessels of the conjunctiva leading to a red appearance of the sclera. Evidence: TAS. Frequency: Frequent (HP:0040282). (ORPHA:137599)
- Herpetiform vesicles (HP:0031448): Multiple vesicles distributed in multiple distinct groups consisting of multiple adjacent vesicles. Evidence: TAS. Frequency: Frequent (HP:0040282). (ORPHA:137599)
- Corneal perforation (HP:0100583): A rupture of the cornea through which a portion of the iris protrudes. Evidence: TAS. Frequency: Frequent (HP:0040282). (ORPHA:137599)
- Keratitis (HP:0000491): Inflammation of the cornea. Evidence: TAS. Frequency: Occasional (HP:0040283). (ORPHA:137599)
- Blindness (HP:0000618): Blindness is the condition of lacking visual perception defined as a profound reduction in visual perception. On the 6m visual acuity scale, blindness is defined as less than 3/60. On the 20ft visual acuity scale, blindness is defined as less than 20/400. On the decimal visual acuity scale, blindness is defined as less than 0.05. Blindness is typically characterized by a visual field of no greater than 10 degrees in radius around central fixation. Evidence: TAS. Frequency: Occasional (HP:0040283). (ORPHA:137599)
- Low-grade fever (HP:0011134): Mild fever that does not exceed 38.5 degrees centigrade. Evidence: TAS. Frequency: Occasional (HP:0040283). (ORPHA:137599)
- Malaise (HP:0033834): A feeling of general discomfort, weakness, or lack of health. Evidence: TAS. Frequency: Occasional (HP:0040283). (ORPHA:137599)